- Difficulty adjusting to changes in luminance (HP:0030512). Evidence: PCS. Frequency: 4/4. (PMID:19818506;PMID:14702087)
- Bradyopsia (HP:0030511): Difficulty in seeing moving objects. Evidence: PCS. Frequency: 5/5. (PMID:19818506;PMID:14702087;PMID:17698770)
- Nystagmus (HP:0000639): Rhythmic, involuntary oscillations of one or both eyes related to abnormality in fixation, conjugate gaze, or vestibular mechanisms. Evidence: PCS. Frequency: 0/4. (PMID:19818506;PMID:14702087)
- Childhood onset (HP:0011463): Onset of disease at the age of between 1 and 5 years. Evidence: PCS. Frequency: 5/5. (PMID:19818506;PMID:14702087;PMID:17698770)
- Photophobia (HP:0000613): Excessive sensitivity to light with the sensation of discomfort or pain in the eyes due to exposure to bright light. Evidence: PCS. Frequency: 5/5. (PMID:19818506;PMID:14702087;PMID:17698770)
- Reduced visual acuity (HP:0007663). Evidence: PCS. Frequency: 5/5. (PMID:19818506;PMID:14702087;PMID:17698770)
- Autosomal recessive inheritance (HP:0000007): A mode of inheritance that is observed for traits related to a gene encoded on one of the autosomes (i.e., the human chromosomes 1-22) in which a trait manifests in individuals with two pathogenic alleles, either homozygotes (two copies of the same mutant allele) or compound heterozygotes (whereby each copy of a gene has a distinct mutant allele). Evidence: PCS. (PMID:14702087)
These phenotypes are associated with the disease prolonged electroretinal response suppression 2 (OMIM:620344).